Phenotypes associated with the disease cataract 45 (OMIM:616851, an entry in Online Mendelian Inheritance in Man):
- Developmental cataract (HP:0000519, a Human Phenotype Ontology term): A cataract that occurs congenitally as the result of a developmental defect, in contrast to the majority of cataracts that occur in adulthood as the result of degenerative changes of the lens. Evidence: PCS. Onset: Congenital onset (HP:0003577, a Human Phenotype Ontology term). (PMID:25804400)
- Autosomal recessive inheritance (HP:0000007, a Human Phenotype Ontology term): A mode of inheritance that is observed for traits related to a gene encoded on one of the autosomes (i.e., the human chromosomes 1-22) in which a trait manifests in individuals with two pathogenic alleles, either homozygotes (two copies of the same mutant allele) or compound heterozygotes (whereby each copy of a gene has a distinct mutant allele). Evidence: PCS. (PMID:25804400)